- Situs inversus totalis (HP:0001696): A left-right reversal (or mirror reflection) of the anatomical location of the major thoracic and abdominal organs. Evidence: PCS. Frequency: 0/3. (PMID:25098561)
- Autosomal recessive inheritance (HP:0000007): A mode of inheritance that is observed for traits related to a gene encoded on one of the autosomes (i.e., the human chromosomes 1-22) in which a trait manifests in individuals with two pathogenic alleles, either homozygotes (two copies of the same mutant allele) or compound heterozygotes (whereby each copy of a gene has a distinct mutant allele). Evidence: PCS. (PMID:25098561)
- Bimanual synkinesia (HP:0001335): Involuntary movements of one hand that accompany and mirror intentional movements of the opposite hand. Evidence: PCS. (PMID:25098561)
These phenotypes are associated with the disease mirror movements 3 (OMIM:616059).